- Basal cell carcinoma (HP:0002671): The presence of a basal cell carcinoma of the skin. Evidence: IEA. (OMIM:605462)
This phenotype is associated with the disease basal cell carcinoma, susceptibility to, 1 (OMIM:605462).